Phenotypes associated with the disease Idiopathic acute eosinophilic pneumonia (ORPHA:724):
- Fever (HP:0001945): Body temperature elevated above the normal range. Evidence: TAS. Frequency: Very frequent (HP:0040281). (ORPHA:724)
- Restrictive ventilatory defect (HP:0002091): A functional defect characterized by reduced total lung capacity (TLC) not associated with abnormalities of expiratory airflow or airway resistance. Spirometrically, a restrictive defect is defined as FEV1 (forced expiratory volume in 1 second) and FVC (forced vital capacity) less than 80 per cent. Restrictive lung disease may be caused by alterations in lung parenchyma or because of a disease of the pleura, chest wall, or neuromuscular apparatus. Evidence: TAS. Frequency: Very frequent (HP:0040281). (ORPHA:724)
- Respiratory insufficiency (HP:0002093). Evidence: TAS. Frequency: Very frequent (HP:0040281). (ORPHA:724)
- Pulmonary infiltrates (HP:0002113). Evidence: TAS. Frequency: Very frequent (HP:0040281). (ORPHA:724)
- Chest pain (HP:0100749): An unpleasant sensation characterized by physical discomfort (such as pricking, throbbing, or aching) localized to the chest. Evidence: TAS. Frequency: Very frequent (HP:0040281). (ORPHA:724)
- Abnormal eosinophil morphology (HP:0001879): An abnormal count or structure of eosinophils. Evidence: TAS. Frequency: Frequent (HP:0040282). (ORPHA:724)
- Abdominal pain (HP:0002027): An unpleasant sensation characterized by physical discomfort (such as pricking, throbbing, or aching) and perceived to originate in the abdomen. Evidence: TAS. Frequency: Frequent (HP:0040282). (ORPHA:724)
- Abnormal pleura morphology (HP:0002103): An abnormality of the pulmonary pleura, the thin, transparent membrane which covers the lungs and lines the inside of the chest walls. Evidence: TAS. Frequency: Frequent (HP:0040282). (ORPHA:724)
- Abnormal pattern of respiration (HP:0002793): An anomaly of the rhythm or depth of breathing. Evidence: TAS. Frequency: Frequent (HP:0040282). (ORPHA:724)
- Myalgia (HP:0003326): Pain in muscle. Evidence: TAS. Frequency: Frequent (HP:0040282). (ORPHA:724)
- Cough (HP:0012735): A sudden, audible expulsion of air from the lungs through a partially closed glottis, preceded by inhalation. Evidence: TAS. Frequency: Frequent (HP:0040282). (ORPHA:724)